Phenotypes associated with the disease Idiopathic hypersomnia (ORPHA:33208):
- Excessive daytime somnolence (HP:0001262): A state of abnormally strong desire for sleep during the daytime. Evidence: TAS. Frequency: Very frequent (HP:0040281). (ORPHA:33208)
- Sleep disturbance (HP:0002360): An abnormal pattern in the quality, quantity, or characteristics of sleep. Evidence: TAS. Frequency: Very frequent (HP:0040281). (ORPHA:33208)
- Excessive daytime somnolence (HP:0001262): A state of abnormally strong desire for sleep during the daytime. Evidence: TAS. Frequency: Very frequent (HP:0040281). (ORPHA:33208)
- Short attention span (HP:0000736): Reduced attention span characterized by distractibility and impulsivity. Evidence: TAS. Frequency: Frequent (HP:0040282). (ORPHA:33208)
- Memory impairment (HP:0002354): An impairment of memory as manifested by a reduced ability to remember things such as dates and names, and increased forgetfulness. Evidence: TAS. Frequency: Frequent (HP:0040282). (ORPHA:33208)
- Brain fog (HP:0033630): Brain fog is a type of transient cognitive dysfunction that comprises a constellation of symptoms that impair intellectual functioning to a level that interferes with daily activities, commonly including forgetfulness, mental slowness, difficulty thinking or focusing, a perceived slowing of mental processing speed, inability to find the right words, a sensation that the mind went blank or is "cloudy". Brain fog tends to recur and may be triggered by factors such as physical fatigue, lack of sleep, and prolonged standing or may appear to occur spontaneously. Evidence: TAS. Frequency: Frequent (HP:0040282). (ORPHA:33208)
- Sleep drunkeness (HP:6000456): Sleep drunkenness refers to the prolonged and pronounced difficulty with awakening from nocturnal sleep and daytime naps. This symptom should be distinguished from the milder and physiologic state of sleep inertia seen even in healthy controls. Evidence: TAS. Frequency: Frequent (HP:0040282). (ORPHA:33208)
- Depression (HP:0000716): Frequently experiencing feelings of being down, miserable, and/or hopeless; struggling to recover from these moods; having a pessimistic outlook on the future; feeling a pervasive sense of shame; having a low self-worth; experiencing thoughts of suicide and engaging in suicidal behavior. Evidence: TAS. Frequency: Occasional (HP:0040283). (ORPHA:33208)
- Hypnagogic hallucination (HP:0002519): Hypnagogic hallucinations are brief hallucinations that occur when falling asleep. Evidence: TAS. Frequency: Occasional (HP:0040283). (ORPHA:33208)
- Hypnopompic hallucination (HP:0006896): Hallucinations occurring during the transition from sleep to wakefulness. Evidence: TAS. Frequency: Occasional (HP:0040283). (ORPHA:33208)
- Sleep paralysis (HP:0025233): Inability to move trunk and limbs and inability to speak during transition into or out of sleep; awareness is preserved and recall is present. Evidence: TAS. Frequency: Occasional (HP:0040283). (ORPHA:33208)
- Snoring (HP:0025267): Deep, noisy breathing during sleep, accompanied by hoarse or harsh sounds, is caused by the vibration of respiratory structures, especially the soft palate. This vibration results in sound due to obstructed air movement during breathing while sleeping. Evidence: TAS. Frequency: Very rare (HP:0040284). (ORPHA:33208)